Phenotypes associated with the disease ovarian gonadoblastoma (OMIM:424500):
- Gonadoblastoma (HP:0000150): The presence of a gonadoblastoma, a neoplasm of a gonad that consists of aggregates of germ cells and sex cord elements. Evidence: IEA. (OMIM:424500)
- Y-linked inheritance (HP:0001450): A mode of inheritance that is observed for traits related to a gene encoded on the Y chromosome. Evidence: IEA. (OMIM:424500)
- Abnormality of metabolism/homeostasis (HP:0001939). Evidence: IEA. (OMIM:424500)